Phenotypes associated with the disease 48,XYYY syndrome (ORPHA:99329):
- Male hypogonadism (HP:0000026): Decreased functionality of the male gonad, i.e., of the testis, with reduced spermatogenesis or testosterone synthesis. Evidence: TAS. Frequency: Very frequent (HP:0040281). (ORPHA:99329)
- Azoospermia (HP:0000027): Absence of any measurable level of sperm,whereby spermatozoa cannot be observed even after centrifugation of the semen pellet. Evidence: TAS. Frequency: Very frequent (HP:0040281). (ORPHA:99329)
- Tall stature (HP:0000098): A height above that which is expected according to age and gender norms. Evidence: TAS. Frequency: Very frequent (HP:0040281). (ORPHA:99329)
- Thick lower lip vermilion (HP:0000179): Increased thickness of the lower lip, leading to a prominent appearance of the lower lip. The height of the vermilion of the lower lip in the midline is more than 2 SD above the mean. Alternatively, an apparently increased height of the vermilion of the lower lip in the frontal view (subjective). Evidence: TAS. Frequency: Very frequent (HP:0040281). (ORPHA:99329)
- High palate (HP:0000218): Height of the palate more than 2 SD above the mean (objective) or palatal height at the level of the first permanent molar more than twice the height of the teeth (subjective). Evidence: TAS. Frequency: Very frequent (HP:0040281). (ORPHA:99329)
- Epicanthus (HP:0000286): A fold of skin starting above the medial aspect of the upper eyelid and arching downward to cover, pass in front of and lateral to the medial canthus. Evidence: TAS. Frequency: Very frequent (HP:0040281). (ORPHA:99329)
- Hypertelorism (HP:0000316): Interpupillary distance more than 2 SD above the mean (alternatively, the appearance of an increased interpupillary distance or widely spaced eyes). Evidence: TAS. Frequency: Very frequent (HP:0040281). (ORPHA:99329)
- Long philtrum (HP:0000343): Distance between nasal base and midline upper lip vermilion border more than 2 SD above the mean. Alternatively, an apparently increased distance between nasal base and midline upper lip vermilion border. Evidence: TAS. Frequency: Very frequent (HP:0040281). (ORPHA:99329)
- Short neck (HP:0000470): Diminished length of the neck. Evidence: TAS. Frequency: Very frequent (HP:0040281). (ORPHA:99329)
- Atypical behavior (HP:0000708): Atypical behavior is an abnormality in a person's actions that can be controlled or modulated by the will of the individual. While abnormal behaviors can be difficult to control, they are distinct from other abnormal actions that cannot be affected by the individual's will. Evidence: TAS. Frequency: Very frequent (HP:0040281). (ORPHA:99329)
- Aggressive behavior (HP:0000718): Behavior or an act aimed at harming a person, animal, or physical property (e.g., acts of physical violence; shouting, swearing, and using harsh language; slashing someone's tires). Evidence: TAS. Frequency: Very frequent (HP:0040281). (ORPHA:99329)
- Low frustration tolerance (HP:0000744): The feeling of frustration can be defined as an emotional reaction that occurs when a desired goal is not achieved. Frustration intolerance is defined as an age-inappropriate response to frustration, characterized by crying or temper tantrums in children, or aggressive or other maladaptive behaviors. Evidence: TAS. Frequency: Very frequent (HP:0040281). (ORPHA:99329)
- Delayed speech and language development (HP:0000750): A degree of language development that is significantly below the norm for a child of a specified age. Evidence: TAS. Frequency: Very frequent (HP:0040281). (ORPHA:99329)
- Global developmental delay (HP:0001263): A delay in the achievement of motor or mental milestones in the domains of development of a child, including motor skills, speech and language, cognitive skills, and social and emotional skills. This term should only be used to describe children younger than five years of age. Evidence: TAS. Frequency: Very frequent (HP:0040281). (ORPHA:99329)
- Abnormal renal morphology (HP:0012210): Any structural anomaly of the kidney. Evidence: TAS. Frequency: Very frequent (HP:0040281). (ORPHA:99329)
- Acne (HP:0001061): A skin condition in which there is an increase in sebum secretion by the pilosebaceous apparatus associated with open comedones (blackheads), closed comedones (whiteheads), and pustular nodules (papules, pustules, and cysts). Evidence: TAS. Frequency: Very frequent (HP:0040281). (ORPHA:99329)
- Intellectual disability (HP:0001249): The term intellectual disability or intellectual developmental disorder is used to describe significantly sub-average intellectual and adaptive functioning based on clinical assessment and as measured by individually administered, appropriately normed, standardized and validated tests of intellectual functioning and adaptive behavior, with onset during the developmental period from infancy through adolescence. Evidence: TAS. Frequency: Very frequent (HP:0040281). (ORPHA:99329)
- Mild intellectual disability (HP:0001256): Mild intellectual disability (ID) is defined as a type of ID characterized by mildly sub-average adaptive functioning and intellectual functioning, with an intelligence quotient (IQ) the range of 50-69. Evidence: TAS. Frequency: Very frequent (HP:0040281). (ORPHA:99329)
- Abnormal foot morphology (HP:0001760): An abnormality of the skeleton of foot. Evidence: TAS. Frequency: Very frequent (HP:0040281). (ORPHA:99329)
- Pes planus (HP:0001763): A foot where the longitudinal arch of the foot is in contact with the ground or floor when the individual is standing; or, in a patient lying supine, a foot where the arch is in contact with the surface of a flat board pressed against the sole of the foot by the examiner with a pressure similar to that expected from weight bearing; or, the height of the arch is reduced. Evidence: TAS. Frequency: Very frequent (HP:0040281). (ORPHA:99329)
- Asthma (HP:0002099): Asthma is characterized by increased responsiveness of the tracheobronchial tree to multiple stimuli, leading to narrowing of the air passages with resultant dyspnea, cough, and wheezing. Evidence: TAS. Frequency: Very frequent (HP:0040281). (ORPHA:99329)
- Recurrent upper respiratory tract infections (HP:0002788): An increased susceptibility to upper respiratory tract infections as manifested by a history of recurrent upper respiratory tract infections (running ears - otitis, sinusitis, pharyngitis, tonsillitis). Evidence: TAS. Frequency: Very frequent (HP:0040281). (ORPHA:99329)
- Radioulnar synostosis (HP:0002974): An abnormal osseous union (fusion) between the radius and the ulna. Evidence: TAS. Frequency: Very frequent (HP:0040281). (ORPHA:99329)
- Dislocated radial head (HP:0003083): A dislocation of the head of the radius from its socket in the elbow joint. Evidence: TAS. Frequency: Very frequent (HP:0040281). (ORPHA:99329)
- Depressed nasal bridge (HP:0005280): Posterior positioning of the nasal root in relation to the overall facial profile for age. Evidence: TAS. Frequency: Very frequent (HP:0040281). (ORPHA:99329)
- Enamel hypoplasia (HP:0006297): Developmental hypoplasia of the dental enamel. Evidence: TAS. Frequency: Very frequent (HP:0040281). (ORPHA:99329)
- Irregularly spaced teeth (HP:0006316): Irregular distribution of the teeth along the dental arch, i.e., and irregular spatial pattern of teeth. Evidence: TAS. Frequency: Very frequent (HP:0040281). (ORPHA:99329)
- Abnormal dermatoglyphics (HP:0007477): An abnormality of dermatoglyphs (fingerprints), which are present on fingers, palms, toes, and soles. Evidence: TAS. Frequency: Very frequent (HP:0040281). (ORPHA:99329)
- Primary gonadal insufficiency (HP:0008193). Evidence: TAS. Frequency: Very frequent (HP:0040281). (ORPHA:99329)
- Feeding difficulties (HP:0011968): Impaired ability to eat related to problems gathering food and getting ready to suck, chew, or swallow it. Evidence: TAS. Frequency: Very frequent (HP:0040281). (ORPHA:99329)
- Impulsivity (HP:0100710): Acting on the spur of the moment or on a momentary basis without consideration of outcomes; having difficulty establishing or following plans; experiencing a sense of urgency and engaging in behavior that is uninhibited, cannot be inhibited, and is uncontrolled. The possibility of repression is inconceivable. Evidence: TAS. Frequency: Very frequent (HP:0040281). (ORPHA:99329)